Phenotypes associated with the disease alveolar rhabdomyosarcoma (OMIM:268220):
- Alveolar rhabdomyosarcoma (HP:0006779). Evidence: TAS. (OMIM:268220)
- Typified by somatic mosaicism (HP:0001442): Description of conditions in which affected individuals typically display somatic mosaicism, i.e., genetically distinct populations of somatic cells in a given organism caused by DNA mutations, epigenetic alterations of DNA, chromosomal abnormalities or the spontaneous reversion of inherited mutations. In many conditions typified by somatic mosaicism, constitutive mutation is lethal and cases are exclusively or predominantly mosaic. Evidence: TAS. (OMIM:268220)